- Deeply set eye (HP:0000490): An eye that is more deeply recessed into the plane of the face than is typical. Evidence: TAS. Frequency: Frequent (HP:0040282). (ORPHA:521390)
- Hypermetropia (HP:0000540): An abnormality of refraction characterized by the ability to see objects in the distance clearly, while objects nearby appear blurry. Evidence: TAS. Frequency: Frequent (HP:0040282). (ORPHA:521390)
- Nystagmus (HP:0000639): Rhythmic, involuntary oscillations of one or both eyes related to abnormality in fixation, conjugate gaze, or vestibular mechanisms. Evidence: TAS. Frequency: Frequent (HP:0040282). (ORPHA:521390)
- Intellectual disability (HP:0001249): The term intellectual disability or intellectual developmental disorder is used to describe significantly sub-average intellectual and adaptive functioning based on clinical assessment and as measured by individually administered, appropriately normed, standardized and validated tests of intellectual functioning and adaptive behavior, with onset during the developmental period from infancy through adolescence. Evidence: TAS. Frequency: Frequent (HP:0040282). (ORPHA:521390)
- Plagiocephaly (HP:0001357): Asymmetric head shape, which is usually a combination of unilateral occipital flattening with ipsilateral frontal prominence, leading to rhomboid cranial shape. Evidence: TAS. Frequency: Frequent (HP:0040282). (ORPHA:521390)
- Obesity (HP:0001513): Accumulation of substantial excess body fat. Evidence: TAS. Frequency: Frequent (HP:0040282). (ORPHA:521390)
- Hypoplasia of the corpus callosum (HP:0002079): Underdevelopment of the corpus callosum. Evidence: TAS. Frequency: Frequent (HP:0040282). (ORPHA:521390)
- Ventriculomegaly (HP:0002119): An increase in size of the ventricular system of the brain. Evidence: TAS. Frequency: Frequent (HP:0040282). (ORPHA:521390)
- Delayed gross motor development (HP:0002194): A type of motor delay characterized by a delay in acquiring the ability to control the large muscles of the body for walking, running, sitting, and crawling. Evidence: TAS. Frequency: Frequent (HP:0040282). (ORPHA:521390)
- Progressive spastic paraplegia (HP:0007020). Evidence: TAS. Frequency: Frequent (HP:0040282). (ORPHA:521390)
- Prominent forehead (HP:0011220): Forward prominence of the entire forehead, due to protrusion of the frontal bone. Evidence: TAS. Frequency: Frequent (HP:0040282). (ORPHA:521390)
- Abnormal CNS myelination (HP:0011400): An abnormality of myelination of nerves in the central nervous system. Evidence: TAS. Frequency: Frequent (HP:0040282). (ORPHA:521390)
- Esophoria (HP:0025312): A form of strabismus with both eyes turned inward to a relatively mild degree, usually defined as less than 10 prism diopters. Evidence: TAS. Frequency: Frequent (HP:0040282). (ORPHA:521390)
- Polyhydramnios (HP:0001561): The presence of excess amniotic fluid in the uterus during pregnancy. Evidence: TAS. Frequency: Occasional (HP:0040283). (ORPHA:521390)
These phenotypes are associated with the disease Spastic paraplegia-intellectual disability-nystagmus-obesity syndrome (ORPHA:521390).